- Poor head control (HP:0002421): Difficulty to maintain correct position of the head while standing or sitting. Infant head lag is observed when the head seems to flop around or lags posteriorly behind the trunk. Several articles have maintained that head lag should be absent by age 3 to 4 months. Evidence: PCS. Frequency: 10/10. (PMID:18571143)
- Strabismus (HP:0000486): A misalignment of the eyes so that the visual axes deviate from bifoveal fixation. The classification of strabismus may be based on a number of features including the relative position of the eyes, whether the deviation is latent or manifest, intermittent or constant, concomitant or otherwise and according to the age of onset and the relevance of any associated refractive error. Evidence: PCS. Frequency: 10/10. (PMID:18571143)
- Babinski sign (HP:0003487): Upturning of the big toe (and sometimes fanning of the other toes) in response to stimulation of the sole of the foot. If the Babinski sign is present it can indicate damage to the corticospinal tract. Evidence: PCS. Frequency: 10/10. (PMID:18571143)
- Choreoathetosis (HP:0001266): Involuntary movements characterized by both athetosis (inability to sustain muscles in a fixed position) and chorea (widespread jerky arrhythmic movements). Evidence: PCS. (PMID:18571143)
- Flexion contracture (HP:0001371): A flexion contracture is a bent (flexed) joint that cannot be straightened actively or passively. It is thus a chronic loss of joint motion due to structural changes in muscle, tendons, ligaments, or skin that prevents normal movement of joints. Evidence: PCS. (PMID:18571143)
- Seizure (HP:0001250): A seizure is an intermittent abnormality of nervous system physiology characterized by a transient occurrence of signs and/or symptoms due to abnormal excessive or synchronous neuronal activity in the brain. Evidence: PCS. Frequency: 6/10. (PMID:18571143)
- Profound intellectual disability (HP:0002187): Profound intellectual disability (ID) is defined as a type of ID characterized by profoundly sub-average adaptive functioning and intellectual functioning, with an intelligence quotient (IQ) below 20. Evidence: PCS. (PMID:18571143)
- Global developmental delay (HP:0001263): A delay in the achievement of motor or mental milestones in the domains of development of a child, including motor skills, speech and language, cognitive skills, and social and emotional skills. This term should only be used to describe children younger than five years of age. Evidence: PCS. Frequency: 10/10. (PMID:18571143)
- Hypotonia (HP:0001252): Hypotonia is an abnormally low muscle tone (the amount of tension or resistance to movement in a muscle). Even when relaxed, muscles have a continuous and passive partial contraction which provides some resistance to passive stretching. Hypotonia thus manifests as diminished resistance to passive stretching. Hypotonia is not the same as muscle weakness, although the two conditions can co-exist. Evidence: PCS. Frequency: 10/10. (PMID:18571143)
- Increased circulating lactate concentration (HP:0002151): Abnormally increased level of blood lactate (2-hydroxypropanoic acid). Lactate is produced from pyruvate by lactate dehydrogenase during normal metabolism. The terms lactate and lactic acid are often used interchangeably but lactate (the component measured in blood) is strictly a weak base whereas lactic acid is the corresponding acid. Lactic acidosis is often used clinically to describe elevated lactate but should be reserved for cases where there is a corresponding acidosis (pH below 7.35). Evidence: PCS. Frequency: 4/10. (PMID:18571143)
- Secondary microcephaly (HP:0005484): Head circumference which falls below 2 standard deviations below the mean for age and gender because of insufficient head growth after birth. Evidence: PCS. Frequency: 10/10. (PMID:18571143)
- Progressive spasticity (HP:0002191): Spasticity that increases in degree with time. Evidence: PCS. Frequency: 10/10. (PMID:18571143)
- Nystagmus (HP:0000639): Rhythmic, involuntary oscillations of one or both eyes related to abnormality in fixation, conjugate gaze, or vestibular mechanisms. Evidence: PCS. Frequency: 9/10. (PMID:18571143)
- Autosomal recessive inheritance (HP:0000007): A mode of inheritance that is observed for traits related to a gene encoded on one of the autosomes (i.e., the human chromosomes 1-22) in which a trait manifests in individuals with two pathogenic alleles, either homozygotes (two copies of the same mutant allele) or compound heterozygotes (whereby each copy of a gene has a distinct mutant allele). Evidence: PCS. (PMID:18571143)
- Feeding difficulties in infancy (HP:0008872): Impaired feeding performance of an infant as manifested by difficulties such as weak and ineffective sucking, brief bursts of sucking, and falling asleep during sucking. There may be difficulties with chewing or maintaining attention. Evidence: PCS. Frequency: 10/10. (PMID:18571143)
- Ethylmalonic aciduria (HP:0003219): The concentration of ethylmalonic acid in the urine, normalized for urine concentration, is above the upper limit of normal. Evidence: PCS. Frequency: 5/8. (PMID:18571143)
- Spastic paraplegia (HP:0001258): Complete loss of the ability to move the lower limbs accompanied by spasticity of the lower limbs. Evidence: PCS. Frequency: 10/10. (PMID:18571143)
- Leukodystrophy (HP:0002415): Leukodystrophy refers to deterioration of white matter of the brain resulting from degeneration of myelin sheaths in the CNS. Their basic defect is directly related to the synthesis and maintenance of myelin membranes. Symmetric white matter involvement at MRI is a typical finding in patients with leukodystrophies. Evidence: PCS. Frequency: 8/8. (PMID:18571143)
- Apnea (HP:0002104): Lack of breathing with no movement of the respiratory muscles and no exchange of air in the lungs. This term refers to a disposition to have recurrent episodes of apnea rather than to a single event. Evidence: PCS. Frequency: 6/10. (PMID:18571143)
- Head titubation (HP:0002599): A head tremor of moderate speed (3 to 4 Hz) in the anterior-posterior direction. Evidence: PCS. Frequency: 10/10. (PMID:18571143)
- Hyperreflexia (HP:0001347): Hyperreflexia is the presence of hyperactive stretch reflexes of the muscles. Evidence: PCS. Frequency: 10/10. (PMID:18571143)
- Neonatal onset (HP:0003623): Onset of signs or symptoms of disease within the first 28 days of life. Evidence: PCS. Frequency: 10/10. (PMID:18571143)
These phenotypes are associated with the disease leukodystrophy, hypomyelinating, 4 (OMIM:612233).